Phenotypes associated with the disease Coronavirus 229E susceptibility (OMIM:122460):
- Susceptibility to coronavirus 229e (HP:0005396): Increased susceptibility to coronavirus 229e, as manifested by recurrent episodes of coronavirus 229e. Evidence: IEA. (OMIM:122460)
- Autosomal dominant inheritance (HP:0000006): A mode of inheritance that is observed for traits related to a gene encoded on one of the autosomes (i.e., the human chromosomes 1-22) in which a trait manifests in heterozygotes. In the context of medical genetics, an autosomal dominant disorder is caused when a single copy of the mutant allele is present. Males and females are affected equally, and can both transmit the disorder with a risk of 50% for each child of inheriting the mutant allele. Evidence: IEA. (OMIM:122460)